- Bilateral tonic-clonic seizure (HP:0002069): A bilateral tonic-clonic seizure is a seizure defined by a tonic (bilateral increased tone, lasting seconds to minutes) and then a clonic (bilateral sustained rhythmic jerking) phase. Evidence: TAS. (OMIM:613863)
- Febrile seizure (within the age range of 3 months to 6 years) (HP:0002373): A febrile seizure is any type of seizure (most often a generalized tonic-clonic seizure) occurring with fever (at least 38 degrees Celsius) but in the absence of central nervous system infection, severe metabolic disturbance or other alternative precipitant in children between the ages of 3 months and 6 years. Evidence: TAS. (OMIM:613863)
- Generalized non-motor (absence) seizure (HP:0002121): A generalized non-motor (absence) seizure is a type of a type of dialeptic seizure that is of electrographically generalized onset. It is a generalized seizure characterized by an interruption of activities, a blank stare, and usually the person will be unresponsive when spoken to. Any ictal motor phenomena are minor in comparison to these non-motor features. Evidence: TAS. (OMIM:613863)
- Atonic seizure (HP:0010819): Atonic seizure is a type of motor seizure characterized by a sudden loss or diminution of muscle tone without apparent preceding myoclonic or tonic event lasting about 1 to 2 seconds, involving head, trunk, jaw, or limb musculature. Evidence: TAS. (OMIM:613863)
- Variable expressivity (HP:0003828): A variable severity of phenotypic features. Evidence: TAS. (OMIM:613863)
- Focal-onset seizure (HP:0007359): A focal-onset seizure is a type of seizure originating within networks limited to one hemisphere. They may be discretely localized or more widely distributed, and may originate in subcortical structures. Evidence: TAS. (OMIM:613863)
- Autosomal dominant inheritance (HP:0000006): A mode of inheritance that is observed for traits related to a gene encoded on one of the autosomes (i.e., the human chromosomes 1-22) in which a trait manifests in heterozygotes. In the context of medical genetics, an autosomal dominant disorder is caused when a single copy of the mutant allele is present. Males and females are affected equally, and can both transmit the disorder with a risk of 50% for each child of inheriting the mutant allele. Evidence: TAS. (OMIM:613863)
These phenotypes are associated with the disease generalized epilepsy with febrile seizures plus, type 7 (OMIM:613863).